Phenotypes associated with the disease autosomal recessive nonsyndromic hearing loss 93 (OMIM:614899):
- Congenital onset (HP:0003577): A phenotypic abnormality that is present at birth. Evidence: PCS. (PMID:22981119)
- Hearing impairment (HP:0000365): A decreased magnitude of the sensory perception of sound. Evidence: PCS. (PMID:22981119)
- Autosomal recessive inheritance (HP:0000007): A mode of inheritance that is observed for traits related to a gene encoded on one of the autosomes (i.e., the human chromosomes 1-22) in which a trait manifests in individuals with two pathogenic alleles, either homozygotes (two copies of the same mutant allele) or compound heterozygotes (whereby each copy of a gene has a distinct mutant allele). Evidence: PCS. (PMID:22981119)